- Keratoconus (HP:0000563): A cone-shaped deformity of the cornea characterized by the presence of corneal distortion secondary to thinning of the apex. Evidence: TAS. (OMIM:614623)
- Autosomal dominant inheritance (HP:0000006): A mode of inheritance that is observed for traits related to a gene encoded on one of the autosomes (i.e., the human chromosomes 1-22) in which a trait manifests in heterozygotes. In the context of medical genetics, an autosomal dominant disorder is caused when a single copy of the mutant allele is present. Males and females are affected equally, and can both transmit the disorder with a risk of 50% for each child of inheriting the mutant allele. Evidence: TAS. (OMIM:614623)
These phenotypes are associated with the disease keratoconus 6 (OMIM:614623).